- Migraine (HP:0002076): Migraine is a chronic neurological disorder characterized by episodic attacks of headache and associated symptoms. Evidence: TAS. Frequency: Very frequent (HP:0040281). (ORPHA:157835)
- Recurrent paroxysmal headache (HP:0002331): Repeated episodes of headache with rapid onset, reaching a peak within minutes and of short duration (less than one hour) with pain that is throbbing, pulsating, or bursting in quality. Evidence: TAS. Frequency: Very frequent (HP:0040281). (ORPHA:157835)
- Ptosis (HP:0000508): The upper eyelid margin is positioned 3 mm or more lower than usual and covers the superior portion of the iris (objective); or, the upper lid margin obscures at least part of the pupil (subjective). Evidence: TAS. Frequency: Frequent (HP:0040282). (ORPHA:157835)
- Photophobia (HP:0000613): Excessive sensitivity to light with the sensation of discomfort or pain in the eyes due to exposure to bright light. Evidence: TAS. Frequency: Frequent (HP:0040282). (ORPHA:157835)
- Phonophobia (HP:0002183): An abnormally heightened sensitivity to loud sounds. Evidence: TAS. Frequency: Frequent (HP:0040282). (ORPHA:157835)
- Epiphora (HP:0009926): Abnormally increased lacrimation, that is, excessive tearing (watering eye). Evidence: TAS. Frequency: Frequent (HP:0040282). (ORPHA:157835)
- Rhinitis (HP:0012384): Inflammation of the nasal mucosa with nasal congestion. Evidence: TAS. Frequency: Frequent (HP:0040282). (ORPHA:157835)
- Conjunctival hyperemia (HP:0030953): Dilatation of the blood vessels of the conjunctiva leading to a red appearance of the sclera. Evidence: TAS. Frequency: Frequent (HP:0040282). (ORPHA:157835)
- Flushing (HP:0031284): Recurrent episodes of redness of the skin together with a sensation of warmth or burning of the affected areas of skin. Evidence: TAS. Frequency: Frequent (HP:0040282). (ORPHA:157835)
- Rhinorrhea (HP:0031417): Increased discharge of mucus from the nose. Evidence: TAS. Frequency: Frequent (HP:0040282). (ORPHA:157835)
- Miosis (HP:0000616): Abnormal (non-physiological) constriction of the pupil. Evidence: TAS. Frequency: Occasional (HP:0040283). (ORPHA:157835)
- Diabetes mellitus (HP:0000819): A group of abnormalities characterized by hyperglycemia and glucose intolerance. Evidence: TAS. Frequency: Occasional (HP:0040283). (ORPHA:157835)
- Hypertension (HP:0000822): The presence of chronic increased pressure in the systemic arterial system. Evidence: TAS. Frequency: Occasional (HP:0040283). (ORPHA:157835)
- Nausea and vomiting (HP:0002017): Nausea is a commonly encountered symptom that has been defined as an unpleasant painless subjective feeling that one will imminently vomit. Vomiting has been defined as the forceful expulsion of the contents of the stomach, duodenum, or jejunum through the oral cavity. While nausea and vomiting are often thought to exist on a temporal continuum, this is not always the case. There are situations when severe nausea may be present without emesis and less frequently, when emesis may be present without preceding nausea. Evidence: TAS. Frequency: Occasional (HP:0040283). (ORPHA:157835)
- Focal sensory seizure with olfactory features (HP:0011161): Seizures characterized by olfactory phenomena as its first clinical manifestation. Evidence: TAS. Frequency: Occasional (HP:0040283). (ORPHA:157835)
- Restless legs (HP:0012452): An irresistible urge to move the legs, usually accompanied by unpleasant sensations deep within the limbs. Symptoms typically begin or worsen during periods of rest or inactivity, are most pronounced in the evening or at night, and are temporarily relieved by movement such as walking or stretching. The disturbance often interferes with the initiation or maintenance of sleep. Evidence: TAS. Frequency: Occasional (HP:0040283). (ORPHA:157835)
- Stiff neck (HP:0025258): A sensation of tightness in the neck when attempting to move it, especially after a period of inactivity. Neck stiffness often involves soreness and difficulty moving the neck, especially when trying to turn the head to the side. Evidence: TAS. Frequency: Occasional (HP:0040283). (ORPHA:157835)
- Neck pain (HP:0030833): An unpleasant sensation characterized by physical discomfort (such as pricking, throbbing, or aching) localized to the neck. Evidence: TAS. Frequency: Occasional (HP:0040283). (ORPHA:157835)
- Palpebral edema (HP:0100540): Edema in the region of the eyelids. Evidence: TAS. Frequency: Occasional (HP:0040283). (ORPHA:157835)
These phenotypes are associated with the disease Paroxysmal hemicrania (ORPHA:157835).
The following phenotypes are NOT associated with this disease:
- Cluster headache (HP:0012199): A type of headache characterized by repeated attacks of unilateral pain lasting 15 to 180 minutes and associated with local autonomic signs. Evidence: TAS. (ORPHA:157835)
- Trigeminal neuralgia (HP:0100661): A neuropathic disorder characterized by episodes of intense pain in the face, originating from the trigeminal nerve. One, two, or all three branches of the nerve may be affected. Evidence: TAS. (ORPHA:157835)